- Axial hypotonia (HP:0008936): Muscular hypotonia (abnormally low muscle tone) affecting the musculature of the trunk. Evidence: TAS. Frequency: Frequent (HP:0040282). (ORPHA:79332)
- Elevated circulating creatine kinase activity (HP:0003236): The activity of creatine kinase in the blood circulation is above the upper limit of normal. Evidence: TAS. Frequency: Very frequent (HP:0040281). (ORPHA:79332)
- Floppy infant (HP:0008947): Floppiness/hypotonia is defined as reduced resistance to passive movement of joints. Physical examination of floppy/hypotonic infants shows head lag, lack of shoulder and elbow muscle contraction on traction response, inability to tighten the shoulder girdle muscles (or slipping through) when held under the axillae, scarf sign (when the arm is pulled to the opposite side, the arm wraps around the neck with the elbow crossing midline), hyperdorsiflexion of the feet, easy apposition of the thumb against the forearm, feet touching the cheek with ease and without discomfort, frog leg position, and inverted U sign on ventral suspension (head, arms, and legs hanging down without elbow or knee flexion and the trunk rounded in a dome shape). Evidence: TAS. Frequency: Very frequent (HP:0040281). (ORPHA:79332)
- Type II transferrin isoform profile (HP:0012301): Abnormal transferrin isoform profile consistent with a type II congenital disorder of glycosylation. Evidence: TAS. Frequency: Very frequent (HP:0040281). (ORPHA:79332)
- Abnormal circulating enzyme concentration or activity (HP:0012379): Concentration or activity of an enzyme is above or below the limits of normal in the blood circulation. Evidence: TAS. Frequency: Very frequent (HP:0040281). (ORPHA:79332)
- Low-set ears (HP:0000369): Upper insertion of the ear to the scalp below an imaginary horizontal line drawn between the inner canthi of the eye and extending posteriorly to the ear. Evidence: TAS. Frequency: Frequent (HP:0040282). (ORPHA:79332)
- Wide nasal bridge (HP:0000431): Increased breadth of the nasal bridge (and with it, the nasal root). Evidence: TAS. Frequency: Frequent (HP:0040282). (ORPHA:79332)
- Myopia (HP:0000545): An abnormality of refraction characterized by the ability to see objects nearby clearly, while objects in the distance appear blurry. Evidence: TAS. Frequency: Frequent (HP:0040282). (ORPHA:79332)
- Reduced antithrombin III activity (HP:0001976): An abnormality of coagulation related to a decreased concentration of antithrombin-III. Evidence: TAS. Frequency: Frequent (HP:0040282). (ORPHA:79332)
- Abnormal facial shape (HP:0001999): An abnormal morphology (form) of the face or its components. Evidence: TAS. Frequency: Frequent (HP:0040282). (ORPHA:79332)
- Elevated circulating hepatic transaminase concentration (HP:0002910): Elevations of the levels of SGOT and SGPT in the serum. SGOT (serum glutamic oxaloacetic transaminase) and SGPT (serum glutamic pyruvic transaminase) are transaminases primarily found in the liver and heart and are released into the bloodstream as the result of liver or heart damage. SGOT and SGPT are used clinically mainly as markers of liver damage. Evidence: TAS. Frequency: Frequent (HP:0040282). (ORPHA:79332)
- Abnormality of the coagulation cascade (HP:0003256): An abnormality of the coagulation cascade, which is comprised of the contact activation pathway (also known as the intrinsic pathway) and the tissue factor pathway (also known as the extrinsic pathway) as well as cofactors and regulators. Evidence: TAS. Frequency: Frequent (HP:0040282). (ORPHA:79332)
- Decreased circulating LDL-C concentration (HP:0003563): The concentration of low-density lipoprotein cholesterol in the blood circulation is below the lower limit of normal. Evidence: TAS. Frequency: Frequent (HP:0040282). (ORPHA:79332)
- Prolonged partial thromboplastin time (HP:0003645): Increased time to coagulation in the partial thromboplastin time (PTT) test, a measure of the intrinsic and common coagulation pathways. Phospholipid, and activator, and calcium are mixed into an anticoagulated plasma sample, and the time is measured until a thrombus forms. Evidence: TAS. Frequency: Frequent (HP:0040282). (ORPHA:79332)
- Reduced protein S activity (HP:0004855): An abnormality of coagulation related to a decreased concentration of vitamin K-dependent protein S. Protein S is a cofactor of protein C. Evidence: TAS. Frequency: Frequent (HP:0040282). (ORPHA:79332)
- Reduced protein C activity (HP:0005543): An abnormality of coagulation related to a decreased concentration of vitamin K-dependent protein C. Protein C is activated to protein Ca by thrombin bound to thrombomodulin. Activated protein C degrades factors VIIIa and Va. Evidence: TAS. Frequency: Frequent (HP:0040282). (ORPHA:79332)
- Thin upper lip vermilion (HP:0000219): Height of the vermilion of the upper lip in the midline more than 2 SD below the mean. Alternatively, an apparently reduced height of the vermilion of the upper lip in the frontal view (subjective). Evidence: TAS. Frequency: Occasional (HP:0040283). (ORPHA:79332)
- Hydrocephalus (HP:0000238): Hydrocephalus is an active distension of the ventricular system of the brain resulting from inadequate passage of CSF from its point of production within the cerebral ventricles to its point of absorption into the systemic circulation. Evidence: TAS. Frequency: Occasional (HP:0040283). (ORPHA:79332)
- Hypertelorism (HP:0000316): Interpupillary distance more than 2 SD above the mean (alternatively, the appearance of an increased interpupillary distance or widely spaced eyes). Evidence: TAS. Frequency: Occasional (HP:0040283). (ORPHA:79332)
- Long philtrum (HP:0000343): Distance between nasal base and midline upper lip vermilion border more than 2 SD above the mean. Alternatively, an apparently increased distance between nasal base and midline upper lip vermilion border. Evidence: TAS. Frequency: Occasional (HP:0040283). (ORPHA:79332)
- Hypothyroidism (HP:0000821): Deficiency of thyroid hormone. Evidence: TAS. Frequency: Occasional (HP:0040283). (ORPHA:79332)
- Edema (HP:0000969): An abnormal accumulation of fluid beneath the skin, or in one or more cavities of the body. Evidence: TAS. Frequency: Occasional (HP:0040283). (ORPHA:79332)
- Dandy-Walker malformation (HP:0001305): A congenital brain malformation typically characterized by incomplete formation of the cerebellar vermis, dilation of the fourth ventricle, and enlargement of the posterior fossa. In layman's terms, Dandy Walker malformation is a cyst in the cerebellum (typically symmetrical) that is involved with the fourth ventricle. This may interfere with the ability to drain cerebrospinal fluid from the brain, resulting in hydrocephalus. Dandy Walker cysts are formed during early embryonic development, while the brain forms. The cyst in the cerebellum typically has several blood vessels running through it connecting to the brain, thereby prohibiting surgical removal. Evidence: TAS. Frequency: Occasional (HP:0040283). (ORPHA:79332)
- Cerebellar hypoplasia (HP:0001321): Cerebellar hypoplasia is a descriptive term implying a cerebellum with a reduced volume, but a normal shape and is stable over time. Evidence: TAS. Frequency: Occasional (HP:0040283). (ORPHA:79332)
- Small for gestational age (HP:0001518): Smaller than normal size according to sex and gestational age related norms, defined as a weight below the 10th percentile for the gestational age. Evidence: TAS. Frequency: Occasional (HP:0040283). (ORPHA:79332)
- Premature birth (HP:0001622): The birth of a baby of less than 37 weeks of gestational age. Evidence: TAS. Frequency: Occasional (HP:0040283). (ORPHA:79332)
- Splenomegaly (HP:0001744): Abnormal increased size of the spleen. Evidence: TAS. Frequency: Occasional (HP:0040283). (ORPHA:79332)
- Abnormal bleeding (HP:0001892): An abnormal susceptibility to bleeding, often referred to as a bleeding diathesis. A bleeding diathesis may be related to vascular, platelet and coagulation defects. Evidence: TAS. Frequency: Occasional (HP:0040283). (ORPHA:79332)
- Diarrhea (HP:0002014): Abnormally increased frequency (usually defined as three or more) loose or watery bowel movements a day. Evidence: TAS. Frequency: Occasional (HP:0040283). (ORPHA:79332)
- Hepatomegaly (HP:0002240): Abnormally increased size of the liver. Evidence: TAS. Frequency: Occasional (HP:0040283). (ORPHA:79332)
- Inverted nipples (HP:0003186): The presence of nipples that instead of pointing outward are retracted inwards. Evidence: TAS. Frequency: Occasional (HP:0040283). (ORPHA:79332)
- Redundant neck skin (HP:0005989): Excess skin around the neck, often lying in horizontal folds. Evidence: TAS. Frequency: Occasional (HP:0040283). (ORPHA:79332)
- High myopia (HP:0011003): A severe form of myopia with greater than -6.00 diopters. Evidence: TAS. Frequency: Occasional (HP:0040283). (ORPHA:79332)
- Inflammatory abnormality of the skin (HP:0011123): The presence of inflammation of the skin. That is, an abnormality of the skin resulting from the local accumulation of fluid, plasma proteins, and leukocytes. Evidence: TAS. Frequency: Occasional (HP:0040283). (ORPHA:79332)
These phenotypes are associated with the disease B4GALT1-CDG (ORPHA:79332).